Phenotypes associated with the disease neurofibromatosis type 1 (DECIPHER:15):
- Neurofibroma (HP:0001067): A benign peripheral nerve sheath tumor that generally appears as a soft, skin-colored papule or small subcutaneous nodule. Individuals with neurofibromatosis can have numerous neurofibromas. Evidence: IEA. (DECIPHER:15)
- Cafe-au-lait spot (HP:0000957): Cafe-au-lait spots are hyperpigmented lesions that can vary in color from light brown to dark brown with smooth borders and having a size of 1.5 cm or more in adults and 0.5 cm or more in children. Evidence: IEA. (DECIPHER:15)
- Hypertelorism (HP:0000316): Interpupillary distance more than 2 SD above the mean (alternatively, the appearance of an increased interpupillary distance or widely spaced eyes). Evidence: IEA. (DECIPHER:15)
- Abnormal heart morphology (HP:0001627): Any structural anomaly of the heart. Evidence: IEA. (DECIPHER:15)
- Coarse facial features (HP:0000280): Absence of fine and sharp appearance of brows, nose, lips, mouth, and chin, usually because of rounded and heavy features or thickened skin with or without thickening of subcutaneous and bony tissues. Evidence: IEA. (DECIPHER:15)
- Intellectual disability (HP:0001249): The term intellectual disability or intellectual developmental disorder is used to describe significantly sub-average intellectual and adaptive functioning based on clinical assessment and as measured by individually administered, appropriately normed, standardized and validated tests of intellectual functioning and adaptive behavior, with onset during the developmental period from infancy through adolescence. Evidence: IEA. (DECIPHER:15)